Phenotypes associated with the disease Renin-angiotensin-aldosterone system-blocker-induced angioedema (ORPHA:100057):
- Angioedema (HP:0100665): Rapid swelling (edema) of the dermis, subcutaneous tissue, mucosa and submucosal tissues of the skin of the face, normally around the mouth, and the mucosa of the mouth and/or throat, as well as the tongue during a period of minutes to several hours. The swelling can also occur elsewhere, typically in the hands. Angioedema is similar to urticaria, but the swelling is subcutaneous rather than on the epidermis. Evidence: TAS. Frequency: Obligate (HP:0040280). (ORPHA:100057)
- Facial edema (HP:0000282). Evidence: TAS. Frequency: Very frequent (HP:0040281). (ORPHA:100057)
- Abnormal capillary physiology (HP:0025018): A functional anomaly of the tiny blood vessels that connect arterioles with venules and whose walls act as semipermeable membranes that mediate the diffusion of fluids and gases between the blood circulation and body tissues. Evidence: TAS. Frequency: Very frequent (HP:0040281). (ORPHA:100057)
- Respiratory distress (HP:0002098): Respiratory distress is objectively observable as the physical or emotional consequences from the experience of dyspnea. The physical presentation of respiratory distress is generally referred to as labored breathing, while the sensation of respiratory distress is called shortness of breath or dyspnea. Evidence: TAS. Frequency: Frequent (HP:0040282). (ORPHA:100057)
- Swollen lip (HP:0031244): Enlargement of the lip typically due to fluid buildup or inflammation. Evidence: TAS. Frequency: Frequent (HP:0040282). (ORPHA:100057)
- Tongue edema (HP:0040315): An abnormal accumulation of fluid and swelling in the tongue. Evidence: TAS. Frequency: Frequent (HP:0040282). (ORPHA:100057)
- Palpebral edema (HP:0100540): Edema in the region of the eyelids. Evidence: TAS. Frequency: Frequent (HP:0040282). (ORPHA:100057)
- Upper airway obstruction (HP:0002781): Increased resistance to the passage of air in the upper airway. Evidence: TAS. Frequency: Occasional (HP:0040283). (ORPHA:100057)
- Erythema (HP:0010783): Redness of the skin, caused by hyperemia of the capillaries in the lower layers of the skin. Evidence: TAS. Frequency: Occasional (HP:0040283). (ORPHA:100057)
- Pharyngeal edema (HP:0011855): Abnormal accumulation of fluid leading to swelling of the pharynx. Evidence: TAS. Frequency: Occasional (HP:0040283). (ORPHA:100057)
- Laryngeal edema (HP:0012027): An abnormal accumulation of fluid and swelling in the tissues of the larynx. Evidence: TAS. Frequency: Occasional (HP:0040283). (ORPHA:100057)
Not associated with this disease:
- Pruritus (HP:0000989): Pruritus is an itch or a sensation that makes a person want to scratch. This term refers to an abnormally increased disposition to experience pruritus. Evidence: TAS. (ORPHA:100057)
- Urticaria (HP:0001025): Raised, well-circumscribed areas of erythema and edema involving the dermis and epidermis. Urticaria is intensely pruritic, and blanches completely with pressure. Evidence: TAS. (ORPHA:100057)